- Abnormal heart morphology (HP:0001627): Any structural anomaly of the heart. Evidence: TAS. Frequency: Frequent (HP:0040282). (ORPHA:494344)
- Postnatal growth retardation (HP:0008897): Slow or limited growth after birth. Evidence: TAS. Frequency: Frequent (HP:0040282). (ORPHA:494344)
- Feeding difficulties (HP:0011968): Impaired ability to eat related to problems gathering food and getting ready to suck, chew, or swallow it. Evidence: TAS. Frequency: Frequent (HP:0040282). (ORPHA:494344)
- Brain imaging abnormality (HP:0410263): An anomaly of metabolism or structure of the brain identified by imaging. Evidence: TAS. Frequency: Frequent (HP:0040282). (ORPHA:494344)
- Cryptorchidism (HP:0000028): Testis in inguinal canal. That is, absence of one or both testes from the scrotum owing to failure of the testis or testes to descend through the inguinal canal to the scrotum. Evidence: TAS. Frequency: Occasional (HP:0040283). (ORPHA:494344)
- Hypospadias (HP:0000047): Abnormal position of urethral meatus on the ventral penile shaft (underside) characterized by displacement of the urethral meatus from the tip of the glans penis to the ventral surface of the penis, scrotum, or perineum. Evidence: TAS. Frequency: Occasional (HP:0040283). (ORPHA:494344)
- Vesicoureteral reflux (HP:0000076): Abnormal (retrograde) movement of urine from the bladder into ureters or kidneys related to inadequacy of the valvular mechanism at the ureterovesicular junction or other causes. Evidence: TAS. Frequency: Occasional (HP:0040283). (ORPHA:494344)
- Abnormality of the genitourinary system (HP:0000119): The presence of any abnormality of the genitourinary system. Evidence: TAS. Frequency: Occasional (HP:0040283). (ORPHA:494344)
- Epicanthus (HP:0000286): A fold of skin starting above the medial aspect of the upper eyelid and arching downward to cover, pass in front of and lateral to the medial canthus. Evidence: TAS. Frequency: Occasional (HP:0040283). (ORPHA:494344)
- Micrognathia (HP:0000347): Developmental hypoplasia of the mandible. Evidence: TAS. Frequency: Occasional (HP:0040283). (ORPHA:494344)
- Posteriorly rotated ears (HP:0000358): A type of abnormal location of the ears in which the position of the ears is characterized by posterior rotation (the superior part of the ears is rotated towards the back of the head, and the inferior part of the ears towards the front). Evidence: TAS. Frequency: Occasional (HP:0040283). (ORPHA:494344)
- Hearing impairment (HP:0000365): A decreased magnitude of the sensory perception of sound. Evidence: TAS. Frequency: Occasional (HP:0040283). (ORPHA:494344)
- Choanal atresia (HP:0000453): Absence or abnormal closure of the choana (the posterior nasal aperture). Most embryologists believe that posterior choanal atresia results from a failure of rupture between the 35th and 38th day of fetal life of the partition which separates the bucconasal or buccopharyngeal membranes. The resultant choanal atresia may be unilateral or bilateral, bony or membranous, complete or incomplete. In over 90 per cent of cases the obstruction is bony, while in the remainder it is membranous. The bony type of atresia is commonly located 1-2 mm. anterior to the posterior edge of the hard palate, and the osseous septum varies in thickness from 1 to 10 mm. In the membranous form of choanal atresia the obstruction usually occurs further posteriorly. In approximately one third of cases the atresia is bilateral. Evidence: TAS. Frequency: Occasional (HP:0040283). (ORPHA:494344)
- Anteverted nares (HP:0000463): Anteriorly-facing nostrils viewed with the head in the Frankfurt horizontal and the eyes of the observer level with the eyes of the subject. This gives the appearance of an upturned nose (upturned nasal tip). Evidence: TAS. Frequency: Occasional (HP:0040283). (ORPHA:494344)
- Astigmatism (HP:0000483): A type of refraction error associated with abnormal curvatures on the anterior and/or posterior surface of the cornea. Evidence: TAS. Frequency: Occasional (HP:0040283). (ORPHA:494344)
- Strabismus (HP:0000486): A misalignment of the eyes so that the visual axes deviate from bifoveal fixation. The classification of strabismus may be based on a number of features including the relative position of the eyes, whether the deviation is latent or manifest, intermittent or constant, concomitant or otherwise and according to the age of onset and the relevance of any associated refractive error. Evidence: TAS. Frequency: Occasional (HP:0040283). (ORPHA:494344)
- Ptosis (HP:0000508): The upper eyelid margin is positioned 3 mm or more lower than usual and covers the superior portion of the iris (objective); or, the upper lid margin obscures at least part of the pupil (subjective). Evidence: TAS. Frequency: Occasional (HP:0040283). (ORPHA:494344)
- Myopia (HP:0000545): An abnormality of refraction characterized by the ability to see objects nearby clearly, while objects in the distance appear blurry. Evidence: TAS. Frequency: Occasional (HP:0040283). (ORPHA:494344)
- Esotropia (HP:0000565): A form of strabismus with one or both eyes turned inward ('crossed') to a relatively severe degree, usually defined as 10 diopters or more. Evidence: TAS. Frequency: Occasional (HP:0040283). (ORPHA:494344)
- Chorioretinal coloboma (HP:0000567): Absence of a region of the retina, retinal pigment epithelium, and choroid. Evidence: TAS. Frequency: Occasional (HP:0040283). (ORPHA:494344)
- Microphthalmia (HP:0000568): A developmental anomaly characterized by abnormal smallness of one or both eyes. Evidence: TAS. Frequency: Occasional (HP:0040283). (ORPHA:494344)
- Exotropia (HP:0000577): A form of strabismus with one or both eyes deviated outward. Evidence: TAS. Frequency: Occasional (HP:0040283). (ORPHA:494344)
- Blepharophimosis (HP:0000581): A fixed reduction in the vertical distance between the upper and lower eyelids with short palpebral fissures. Evidence: TAS. Frequency: Occasional (HP:0040283). (ORPHA:494344)
- Iris coloboma (HP:0000612): A coloboma of the iris. Evidence: TAS. Frequency: Occasional (HP:0040283). (ORPHA:494344)
- Optic atrophy (HP:0000648): Atrophy of the optic nerve. Optic atrophy results from the death of the retinal ganglion cell axons that comprise the optic nerve and manifesting as a pale optic nerve on fundoscopy. Evidence: TAS. Frequency: Occasional (HP:0040283). (ORPHA:494344)
- Peters anomaly (HP:0000659): A form of anterior segment dysgenesis in which abnormal cleavage of the anterior chamber occurs. Peters anomaly is characterized by central, paracentral, or complete corneal opacity. Evidence: TAS. Frequency: Occasional (HP:0040283). (ORPHA:494344)
- Atypical behavior (HP:0000708): Atypical behavior is an abnormality in a person's actions that can be controlled or modulated by the will of the individual. While abnormal behaviors can be difficult to control, they are distinct from other abnormal actions that cannot be affected by the individual's will. Evidence: TAS. Frequency: Occasional (HP:0040283). (ORPHA:494344)
- Autistic behavior (HP:0000729): Persistent deficits in social interaction and communication and interaction as well as a markedly restricted repertoire of activity and interest as well as repetitive patterns of behavior. Evidence: TAS. Frequency: Occasional (HP:0040283). (ORPHA:494344)
- Seizure (HP:0001250): A seizure is an intermittent abnormality of nervous system physiology characterized by a transient occurrence of signs and/or symptoms due to abnormal excessive or synchronous neuronal activity in the brain. Evidence: TAS. Frequency: Occasional (HP:0040283). (ORPHA:494344)
- Cerebellar vermis hypoplasia (HP:0001320): Underdevelopment of the vermis of cerebellum. Evidence: TAS. Frequency: Occasional (HP:0040283). (ORPHA:494344)
- Hip dysplasia (HP:0001385): The presence of developmental dysplasia of the hip. Evidence: TAS. Frequency: Occasional (HP:0040283). (ORPHA:494344)
- Ventricular septal defect (HP:0001629): A hole between the two bottom chambers (ventricles) of the heart. The defect is centered around the most superior aspect of the ventricular septum. Evidence: TAS. Frequency: Occasional (HP:0040283). (ORPHA:494344)
- Abnormal facial shape (HP:0001999): An abnormal morphology (form) of the face or its components. Evidence: TAS. Frequency: Occasional (HP:0040283). (ORPHA:494344)
- Frontal bossing (HP:0002007): Bilateral bulging of the lateral frontal bone prominences with relative sparing of the midline. Evidence: TAS. Frequency: Occasional (HP:0040283). (ORPHA:494344)
- Dysphagia (HP:0002015): Difficulty in swallowing. Evidence: TAS. Frequency: Occasional (HP:0040283). (ORPHA:494344)
- Gastroesophageal reflux (HP:0002020): A condition in which the stomach contents leak backwards from the stomach into the esophagus through the lower esophageal sphincter. Evidence: TAS. Frequency: Occasional (HP:0040283). (ORPHA:494344)
- Poor suck (HP:0002033): An inadequate sucking reflex, resulting in the difficult of newborns to be breast-fed. Evidence: TAS. Frequency: Occasional (HP:0040283). (ORPHA:494344)
- Hypoplasia of the corpus callosum (HP:0002079): Underdevelopment of the corpus callosum. Evidence: TAS. Frequency: Occasional (HP:0040283). (ORPHA:494344)
- Ventriculomegaly (HP:0002119): An increase in size of the ventricular system of the brain. Evidence: TAS. Frequency: Occasional (HP:0040283). (ORPHA:494344)
- Scoliosis (HP:0002650): The presence of an abnormal lateral curvature of the spine. Evidence: TAS. Frequency: Occasional (HP:0040283). (ORPHA:494344)
- Attention deficit hyperactivity disorder (HP:0007018): Attention deficit hyperactivity disorder (ADHD) manifests at age 2-3 years or by first grade at the latest. The main symptoms are distractibility, impulsivity, hyperactivity, and often trouble organizing tasks and projects, difficulty going to sleep, and social problems from being aggressive, loud, or impatient. Evidence: TAS. Frequency: Occasional (HP:0040283). (ORPHA:494344)
- CNS demyelination (HP:0007305): A loss of myelin from nerve fibers in the central nervous system. Evidence: TAS. Frequency: Occasional (HP:0040283). (ORPHA:494344)
- Broad eyebrow (HP:0011229): Regional increase in the width (height) of the eyebrow. Evidence: TAS. Frequency: Occasional (HP:0040283). (ORPHA:494344)
- Anisometropia (HP:0012803): Inequality of refractive power of the two eyes. Evidence: TAS. Frequency: Occasional (HP:0040283). (ORPHA:494344)
- Abnormal cranial nerve physiology (HP:0031910): A functional abnormality affecting one or more of the cranial nerves, which emerge directly from the brain stem. Evidence: TAS. Frequency: Occasional (HP:0040283). (ORPHA:494344)
- Cerebral visual impairment (HP:0100704): A form of loss of vision caused by damage to the visual cortex rather than a defect in the eye. Evidence: TAS. Frequency: Occasional (HP:0040283). (ORPHA:494344)
- Self-injurious behavior (HP:0100716): Self-aggression. Evidence: TAS. Frequency: Occasional (HP:0040283). (ORPHA:494344)
- Abnormality of the eye (HP:0000478): Any abnormality of the eye, including location, spacing, and intraocular abnormalities. Evidence: TAS. Frequency: Frequent (HP:0040282). (ORPHA:494344)
- Intellectual disability (HP:0001249): The term intellectual disability or intellectual developmental disorder is used to describe significantly sub-average intellectual and adaptive functioning based on clinical assessment and as measured by individually administered, appropriately normed, standardized and validated tests of intellectual functioning and adaptive behavior, with onset during the developmental period from infancy through adolescence. Evidence: TAS. Frequency: Frequent (HP:0040282). (ORPHA:494344)
- Hypotonia (HP:0001252): Hypotonia is an abnormally low muscle tone (the amount of tension or resistance to movement in a muscle). Even when relaxed, muscles have a continuous and passive partial contraction which provides some resistance to passive stretching. Hypotonia thus manifests as diminished resistance to passive stretching. Hypotonia is not the same as muscle weakness, although the two conditions can co-exist. Evidence: TAS. Frequency: Frequent (HP:0040282). (ORPHA:494344)
- Global developmental delay (HP:0001263): A delay in the achievement of motor or mental milestones in the domains of development of a child, including motor skills, speech and language, cognitive skills, and social and emotional skills. This term should only be used to describe children younger than five years of age. Evidence: TAS. Frequency: Frequent (HP:0040282). (ORPHA:494344)
- Intrauterine growth retardation (HP:0001511): An abnormal restriction of fetal growth with fetal weight below the tenth percentile for gestational age. Evidence: TAS. Frequency: Frequent (HP:0040282). (ORPHA:494344)
These phenotypes are associated with the disease RERE-related neurodevelopmental syndrome (ORPHA:494344).